Phenotypes associated with the disease self-limited epilepsy with centrotemporal spikes (OMIM:117100):
- Bilateral tonic-clonic seizure with focal onset (HP:0007334): A bilateral tonic-clonic seizure with focal onset is a focal-onset seizure which progresses into a bilateral tonic-clonic phase. Evidence: TAS. (OMIM:117100)
- Sporadic (HP:0003745): Cases of the disease in question occur without a previous family history, i.e., as isolated cases without being transmitted from a parent and without other siblings being affected. Evidence: TAS. (OMIM:117100)
- Nocturnal seizures (HP:0031951): Seizures that occur while the affected individual is sleeping. Evidence: IEA. (OMIM:117100)
- Focal-onset seizure (HP:0007359): A focal-onset seizure is a type of seizure originating within networks limited to one hemisphere. They may be discretely localized or more widely distributed, and may originate in subcortical structures. Evidence: TAS. (OMIM:117100)
- EEG with centrotemporal focal spike waves (HP:0012557): EEG with focal sharp transient waves in the centrotemporal region of the brain (also known as the central sulcus), i.e., focal sharp waves of a duration less than 80 msec followed by a slow wave. Evidence: TAS. (OMIM:117100)